- Short hallux (HP:0010109): Underdevelopment (hypoplasia) of the big toe. Evidence: PCS. (PMID:29270563)
- Proximal fifth finger symphalangism (HP:0009177): Fusion of the proximal and middle phalanges of the 5th finger. Evidence: IEA. (OMIM:186750)
- Foot pain (HP:0025238): An unpleasant sensation characterized by physical discomfort (such as pricking, throbbing, or aching) localized to the foot. Evidence: PCS. (PMID:29270563)
- Clinodactyly of the 5th finger (HP:0004209): Clinodactyly refers to a bending or curvature of the fifth finger in the radial direction (i.e., towards the 4th finger). Evidence: IEA. (OMIM:186750)
- Coalescence of tarsal bones (HP:0005802). Evidence: PCS. (PMID:29270563)
- Autosomal dominant inheritance (HP:0000006): A mode of inheritance that is observed for traits related to a gene encoded on one of the autosomes (i.e., the human chromosomes 1-22) in which a trait manifests in heterozygotes. In the context of medical genetics, an autosomal dominant disorder is caused when a single copy of the mutant allele is present. Males and females are affected equally, and can both transmit the disorder with a risk of 50% for each child of inheriting the mutant allele. Evidence: IEA. (OMIM:186750)
- Abnormality of the ankle (HP:0003028): An anomaly of the joint that connects the foot with the leg. Evidence: PCS. (PMID:29270563)
These phenotypes are associated with the disease talonavicular coalition (OMIM:186750).